- Cervical lymphadenopathy (HP:0025289): Enlarged lymph nodes in the neck. Evidence: TAS. Frequency: Very frequent (HP:0040281). (ORPHA:50918)
- Oral ulcer (HP:0000155): Erosion of the mucous mebrane of the mouth with local excavation of the surface, resulting from the sloughing of inflammatory necrotic tissue. Evidence: TAS. Frequency: Frequent (HP:0040282). (ORPHA:50918)
- Skin rash (HP:0000988): A red eruption of the skin. Evidence: TAS. Frequency: Frequent (HP:0040282). (ORPHA:50918)
- Pruritus (HP:0000989): Pruritus is an itch or a sensation that makes a person want to scratch. This term refers to an abnormally increased disposition to experience pruritus. Evidence: TAS. Frequency: Frequent (HP:0040282). (ORPHA:50918)
- Cutaneous photosensitivity (HP:0000992): An increased sensitivity of the skin to light. Photosensitivity may result in a rash upon exposure to the sun (which is known as photodermatosis). Photosensitivity can be diagnosed by phototests in which light is shone on small areas of skin. Evidence: TAS. Frequency: Frequent (HP:0040282). (ORPHA:50918)
- Alopecia (HP:0001596): A noncongenital process of hair loss, which may progress to partial or complete baldness. Evidence: TAS. Frequency: Frequent (HP:0040282). (ORPHA:50918)
- Weight loss (HP:0001824): Reduction of total body weight. Evidence: TAS. Frequency: Frequent (HP:0040282). (ORPHA:50918)
- Decreased total leukocyte count (HP:0001882): An abnormal decreased number of leukocytes in the blood. Evidence: TAS. Frequency: Frequent (HP:0040282). (ORPHA:50918)
- Anorexia (HP:0002039): Lack of desire to eat (loss of appetite). Evidence: TAS. Frequency: Frequent (HP:0040282). (ORPHA:50918)
- Vasculitis (HP:0002633): Inflammation of blood vessel. Evidence: TAS. Frequency: Frequent (HP:0040282). (ORPHA:50918)
- Lymphadenopathy (HP:0002716): Enlargement (swelling) of a lymph node. Evidence: TAS. Frequency: Frequent (HP:0040282). (ORPHA:50918)
- Abnormal lymph node morphology (HP:0002733): A structural lymph node abnormality. Evidence: TAS. Frequency: Frequent (HP:0040282). (ORPHA:50918)
- Erythema (HP:0010783): Redness of the skin, caused by hyperemia of the capillaries in the lower layers of the skin. Evidence: TAS. Frequency: Frequent (HP:0040282). (ORPHA:50918)
- Low-grade fever (HP:0011134): Mild fever that does not exceed 38.5 degrees centigrade. Evidence: TAS. Frequency: Frequent (HP:0040282). (ORPHA:50918)
- Fatigue (HP:0012378): A subjective feeling of tiredness characterized by a lack of energy and motivation. Evidence: TAS. Frequency: Frequent (HP:0040282). (ORPHA:50918)
- Chills (HP:0025143): A sudden sensation of feeling cold. Evidence: TAS. Frequency: Frequent (HP:0040282). (ORPHA:50918)
- Malar rash (HP:0025300): An erythematous (red), flat facial rash that affects the skin in the malar area (over the cheekbones) and extends over the bridge of the nose. Evidence: TAS. Frequency: Frequent (HP:0040282). (ORPHA:50918)
- Increased circulating lactate dehydrogenase concentration (HP:0025435): An elevated level of the enzyme lactate dehydrogenase in the blood circulation. Evidence: TAS. Frequency: Frequent (HP:0040282). (ORPHA:50918)
- Night sweats (HP:0030166): Occurrence of excessive sweating during sleep. Evidence: TAS. Frequency: Frequent (HP:0040282). (ORPHA:50918)
- Palpebral edema (HP:0100540): Edema in the region of the eyelids. Evidence: TAS. Frequency: Frequent (HP:0040282). (ORPHA:50918)
- Vasculitis in the skin (HP:0200029): A type of vasculitis (inflammation of blood vessel walls) that affects skeletal muscle tissue. Evidence: TAS. Frequency: Frequent (HP:0040282). (ORPHA:50918)
- Skin nodule (HP:0200036): Morphologically similar to a papule, but greater than either 10mm in both width and depth, and most frequently centered in the dermis or subcutaneous fat. Evidence: TAS. Frequency: Frequent (HP:0040282). (ORPHA:50918)
- Abnormality of the neck (HP:0000464): An abnormality of the neck. Evidence: TAS. Frequency: Occasional (HP:0040283). (ORPHA:50918)
- Meningitis (HP:0001287): Inflammation of the meninges. Evidence: TAS. Frequency: Occasional (HP:0040283). (ORPHA:50918)
- Splenomegaly (HP:0001744): Abnormal increased size of the spleen. Evidence: TAS. Frequency: Occasional (HP:0040283). (ORPHA:50918)
- Thrombocytopenia (HP:0001873): A reduction in the number of circulating thrombocytes. Evidence: TAS. Frequency: Occasional (HP:0040283). (ORPHA:50918)
- Decreased total neutrophil count (HP:0001875): Abnormal decrease of absolute number of neutrophils in the blood, per microlitre, compared to a reference range for a given sex and age-group. Evidence: TAS. Frequency: Occasional (HP:0040283). (ORPHA:50918)
- Anemia (HP:0001903): A reduction in erythrocytes volume or hemoglobin concentration. Evidence: TAS. Frequency: Occasional (HP:0040283). (ORPHA:50918)
- Arthralgia (HP:0002829): Joint pain. Evidence: TAS. Frequency: Occasional (HP:0040283). (ORPHA:50918)
- Elevated circulating hepatic transaminase concentration (HP:0002910): Elevations of the levels of SGOT and SGPT in the serum. SGOT (serum glutamic oxaloacetic transaminase) and SGPT (serum glutamic pyruvic transaminase) are transaminases primarily found in the liver and heart and are released into the bloodstream as the result of liver or heart damage. SGOT and SGPT are used clinically mainly as markers of liver damage. Evidence: TAS. Frequency: Occasional (HP:0040283). (ORPHA:50918)
- Myalgia (HP:0003326): Pain in muscle. Evidence: TAS. Frequency: Occasional (HP:0040283). (ORPHA:50918)
- Antinuclear antibody positivity (HP:0003493): The presence of autoantibodies in the serum that react against nuclei or nuclear components. Evidence: TAS. Frequency: Occasional (HP:0040283). (ORPHA:50918)
- Elevated erythrocyte sedimentation rate (HP:0003565): An increased erythrocyte sedimentation rate (ESR). The ESR is a test that measures the distance that erythrocytes have fallen after one hour in a vertical column of anticoagulated blood under the influence of gravity. The ESR is a nonspecific finding. An elevation may indicate inflammation or may be caused by any condition that elevates fibrinogen. Evidence: TAS. Frequency: Occasional (HP:0040283). (ORPHA:50918)
- Abnormal pulmonary interstitial morphology (HP:0006530): Abnormality of the lung parenchyma extending to the pulmonary interstitium and leading to diffuse pulmonary fibrosis. Evidence: TAS. Frequency: Occasional (HP:0040283). (ORPHA:50918)
- Abnormal blistering of the skin (HP:0008066): The presence of one or more bullae on the skin, defined as fluid-filled blisters more than 5 mm in diameter with thin walls. Evidence: TAS. Frequency: Occasional (HP:0040283). (ORPHA:50918)
- Abnormality of the gastrointestinal tract (HP:0011024): An abnormality of the gastrointestinal tract. Evidence: TAS. Frequency: Occasional (HP:0040283). (ORPHA:50918)
- Elevated circulating C-reactive protein concentration (HP:0011227): The concentration of C-reactive protein in the blood circulation is above the upper limit of normal. Evidence: TAS. Frequency: Occasional (HP:0040283). (ORPHA:50918)
- Enlargement of parotid gland (HP:0011801): Increased size of the parotid gland. Evidence: TAS. Frequency: Occasional (HP:0040283). (ORPHA:50918)
- Macule (HP:0012733): A flat, distinct, discolored area of skin less than 1 cm wide that does not involve any change in the thickness or texture of the skin. Evidence: TAS. Frequency: Occasional (HP:0040283). (ORPHA:50918)
- Erythematous macule (HP:0025475): A macule (flat, distinct, discolored area of skin less than 1 cm wide that does not involve any change in the thickness or texture of the skin) with a red or reddish color often associated with inflammation or irritation. Evidence: TAS. Frequency: Occasional (HP:0040283). (ORPHA:50918)
- Increased total lymphocyte count (HP:0100827): Increase in the number or proportion of lymphocytes in the blood. Evidence: TAS. Frequency: Occasional (HP:0040283). (ORPHA:50918)
- Papule (HP:0200034): A circumscribed, solid elevation of skin with no visible fluid, varying in size from a pinhead to less than 10mm in diameter at the widest point. Evidence: TAS. Frequency: Occasional (HP:0040283). (ORPHA:50918)
- Skin plaque (HP:0200035): A plaque is a solid, raised, plateau-like (flat-topped) lesion greater than 1 cm in diameter. Evidence: TAS. Frequency: Occasional (HP:0040283). (ORPHA:50918)
- Skin erosion (HP:0200041): A discontinuity of the skin exhibiting incomplete loss of the epidermis, a lesion that is moist, circumscribed, and usually depressed. Evidence: TAS. Frequency: Occasional (HP:0040283). (ORPHA:50918)
- Ataxia (HP:0001251): Ataxia refers to impaired coordination of voluntary muscle movement. Cerebellar ataxia refers to ataxia due to dysfunction of the cerebellum. This causes a variety of elementary neurological deficits including asynergy (lack of coordination between muscles, limbs and joints), dysmetria (lack of ability to judge distances that can lead to under- or overshoot in grasping movements), and dysdiadochokinesia (inability to perform rapid movements requiring antagonizing muscle groups to be switched on and off repeatedly). Evidence: TAS. Frequency: Very rare (HP:0040284). (ORPHA:50918)
- Pleural effusion (HP:0002202): The presence of an excessive amount of fluid in the pleural cavity. Evidence: TAS. Frequency: Very rare (HP:0040284). (ORPHA:50918)
- Hepatomegaly (HP:0002240): Abnormally increased size of the liver. Evidence: TAS. Frequency: Very rare (HP:0040284). (ORPHA:50918)
- Generalized lymphadenopathy (HP:0008940): A generalized form of lymphadenopathy. Evidence: TAS. Frequency: Very rare (HP:0040284). (ORPHA:50918)
- Myocarditis (HP:0012819): Inflammation of the myocardium. Evidence: TAS. Frequency: Very rare (HP:0040284). (ORPHA:50918)
- Pustule (HP:0200039): A small elevation of the skin containing cloudy or purulent material usually consisting of necrotic inflammatory cells. Evidence: TAS. Frequency: Very rare (HP:0040284). (ORPHA:50918)
These phenotypes are associated with the disease Kikuchi-Fujimoto disease (ORPHA:50918).